- Abnormality of the face (HP:0000271): An abnormality of the face. Evidence: IEA. (OMIM:161500)
- Autosomal dominant inheritance (HP:0000006): A mode of inheritance that is observed for traits related to a gene encoded on one of the autosomes (i.e., the human chromosomes 1-22) in which a trait manifests in heterozygotes. In the context of medical genetics, an autosomal dominant disorder is caused when a single copy of the mutant allele is present. Males and females are affected equally, and can both transmit the disorder with a risk of 50% for each child of inheriting the mutant allele. Evidence: IEA. (OMIM:161500)
These phenotypes are associated with the disease nasal groove, familial transverse (OMIM:161500).